- Infantile onset (HP:0003593): Onset of signs or symptoms of disease between 28 days to one year of life. Evidence: TAS. (OMIM:127500)
- Hyperpigmented/hypopigmented macules (HP:0007441). Evidence: IEA. (OMIM:127500)
- Autosomal dominant inheritance (HP:0000006): A mode of inheritance that is observed for traits related to a gene encoded on one of the autosomes (i.e., the human chromosomes 1-22) in which a trait manifests in heterozygotes. In the context of medical genetics, an autosomal dominant disorder is caused when a single copy of the mutant allele is present. Males and females are affected equally, and can both transmit the disorder with a risk of 50% for each child of inheriting the mutant allele. Evidence: IEA. (OMIM:127500)
These phenotypes are associated with the disease dyschromatosis universalis hereditaria 1 (OMIM:127500).